- Congenital onset (HP:0003577): A phenotypic abnormality that is present at birth. Evidence: PCS. Frequency: 3/3. (PMID:21983783)
- Delayed speech and language development (HP:0000750): A degree of language development that is significantly below the norm for a child of a specified age. Evidence: PCS. Frequency: 3/3. (PMID:21983783)
- Short stature (HP:0004322): A height below that which is expected according to age and gender norms. Although there is no universally accepted definition of short stature, many refer to "short stature" as height more than 2 standard deviations below the mean for age and gender (or below the 3rd percentile for age and gender dependent norms). Evidence: PCS. Frequency: 3/3. (PMID:21983783)
- Primary microcephaly (HP:0011451): Head circumference below 2 standard deviations below the mean for age and gender at birth. Evidence: PCS. Frequency: 3/3. Onset: Congenital onset (HP:0003577). (PMID:21983783)
- Autosomal recessive inheritance (HP:0000007): A mode of inheritance that is observed for traits related to a gene encoded on one of the autosomes (i.e., the human chromosomes 1-22) in which a trait manifests in individuals with two pathogenic alleles, either homozygotes (two copies of the same mutant allele) or compound heterozygotes (whereby each copy of a gene has a distinct mutant allele). Evidence: PCS. (PMID:21983783)
- Intellectual disability (HP:0001249): The term intellectual disability or intellectual developmental disorder is used to describe significantly sub-average intellectual and adaptive functioning based on clinical assessment and as measured by individually administered, appropriately normed, standardized and validated tests of intellectual functioning and adaptive behavior, with onset during the developmental period from infancy through adolescence. Evidence: PCS. Frequency: 3/3. (PMID:21983783)
These phenotypes are associated with the disease Seckel syndrome 6 (OMIM:614728).